- Abnormality of metabolism/homeostasis (HP:0001939). Evidence: IEA. (OMIM:275240)
- Autosomal recessive inheritance (HP:0000007): A mode of inheritance that is observed for traits related to a gene encoded on one of the autosomes (i.e., the human chromosomes 1-22) in which a trait manifests in individuals with two pathogenic alleles, either homozygotes (two copies of the same mutant allele) or compound heterozygotes (whereby each copy of a gene has a distinct mutant allele). Evidence: IEA. (OMIM:275240)
- Abnormality of the skin (HP:0000951): An abnormality of the skin. Evidence: IEA. (OMIM:275240)
These phenotypes are associated with the disease Kerion celsi (OMIM:275240).